- Juvenile onset (HP:0003621): Onset of signs or symptoms of disease between the age of 5 and 15 years. Evidence: PCS. Frequency: 1/2. (PMID:31472902)
- Mesangial hypercellularity (HP:0012574): Increased numbers of mesangial cells per glomerulus, defined as more than 3 nuclei fully surrounded by matrix in one or more mesangial areas, not including perihilar region, on a standard 3-micron-thick tissue section, best evaluated on periodic acid-Schiff (PAS) stain. Evidence: PCS. Frequency: 1/2. (PMID:31472902)
- Childhood onset (HP:0011463): Onset of disease at the age of between 1 and 5 years. Evidence: PCS. Frequency: 1/2. (PMID:31472902)
- Focal segmental glomerulosclerosis (HP:0000097): Segmental accumulation of scar tissue in individual (but not all) glomeruli. Evidence: PCS. Frequency: 1/2. (PMID:31472902)
- Autosomal recessive inheritance (HP:0000007): A mode of inheritance that is observed for traits related to a gene encoded on one of the autosomes (i.e., the human chromosomes 1-22) in which a trait manifests in individuals with two pathogenic alleles, either homozygotes (two copies of the same mutant allele) or compound heterozygotes (whereby each copy of a gene has a distinct mutant allele). Evidence: PCS. (PMID:31472902)
- Podocyte foot process effacement (HP:0031266): An anomaly of podocyte morphology characterized by the loss of the interdigitating foot process pattern (generally called foot process effacement; FPE). The term FPE designates the loss of the usual interdigitating pattern of foot processes of neighboring podocytes, leading to relatively broad expanses of podocyte processes covering the glomerular basement membrane (GBM). It is widely viewed as a pathological derangement that is associated with leakage of macromolecules such as albumin through the glomerular filtration barrier. Evidence: PCS. Frequency: 1/2. (PMID:31472902)
- Proteinuria (HP:0000093): Increased levels of protein in the urine. Evidence: PCS. Frequency: 2/2. (PMID:31472902)
- Steroid-resistant nephrotic syndrome (HP:0012588): A form of nephrotic syndrome that does not respond to treatment with steroid medication, defined as persistent proteinuria despite 60mg/m2 or 2mg/kg for 8 weeks, after insuring no infection or non-adherence to medication. Evidence: PCS. Frequency: 2/2. (PMID:31472902)
- Minimal change glomerulonephritis (HP:0012579): The presence of minimal changes visible by light microscopy but flattened and fused podocyte foot processes on electron microscopy in a person with nephrotic range proteinuria. Evidence: PCS. Frequency: 1/2. (PMID:31472902)
These phenotypes are associated with the disease nephrotic syndrome, type 23 (OMIM:619201).